- High palate (HP:0000218): Height of the palate more than 2 SD above the mean (objective) or palatal height at the level of the first permanent molar more than twice the height of the teeth (subjective). Evidence: TAS. Frequency: Very frequent (HP:0040281). (ORPHA:353277)
- Facial grimacing (HP:0000273). Evidence: TAS. Frequency: Very frequent (HP:0040281). (ORPHA:353277)
- Hypertelorism (HP:0000316): Interpupillary distance more than 2 SD above the mean (alternatively, the appearance of an increased interpupillary distance or widely spaced eyes). Evidence: TAS. Frequency: Very frequent (HP:0040281). (ORPHA:353277)
- Micrognathia (HP:0000347): Developmental hypoplasia of the mandible. Evidence: TAS. Frequency: Very frequent (HP:0040281). (ORPHA:353277)
- Low-set ears (HP:0000369): Upper insertion of the ear to the scalp below an imaginary horizontal line drawn between the inner canthi of the eye and extending posteriorly to the ear. Evidence: TAS. Frequency: Very frequent (HP:0040281). (ORPHA:353277)
- Downslanted palpebral fissures (HP:0000494): The palpebral fissure inclination is more than two standard deviations below the mean. Evidence: TAS. Frequency: Very frequent (HP:0040281). (ORPHA:353277)
- Delayed speech and language development (HP:0000750): A degree of language development that is significantly below the norm for a child of a specified age. Evidence: TAS. Frequency: Very frequent (HP:0040281). (ORPHA:353277)
- Intellectual disability (HP:0001249): The term intellectual disability or intellectual developmental disorder is used to describe significantly sub-average intellectual and adaptive functioning based on clinical assessment and as measured by individually administered, appropriately normed, standardized and validated tests of intellectual functioning and adaptive behavior, with onset during the developmental period from infancy through adolescence. Evidence: TAS. Frequency: Very frequent (HP:0040281). (ORPHA:353277)
- Abnormal facial shape (HP:0001999): An abnormal morphology (form) of the face or its components. Evidence: TAS. Frequency: Very frequent (HP:0040281). (ORPHA:353277)
- Highly arched eyebrow (HP:0002553): Increased height of the central portion of the eyebrow, forming a crescent, semicircular, or inverted U shape. Evidence: TAS. Frequency: Very frequent (HP:0040281). (ORPHA:353277)
- Prominent nasal septum (HP:0005322). Evidence: TAS. Frequency: Very frequent (HP:0040281). (ORPHA:353277)
- Widened distal phalanges (HP:0006200). Evidence: TAS. Frequency: Very frequent (HP:0040281). (ORPHA:353277)
- Postnatal growth retardation (HP:0008897): Slow or limited growth after birth. Evidence: TAS. Frequency: Very frequent (HP:0040281). (ORPHA:353277)
- Broad hallux (HP:0010055): Visible increase in width of the hallux without an increase in the dorso-ventral dimension. Evidence: TAS. Frequency: Very frequent (HP:0040281). (ORPHA:353277)
- Broad thumb (HP:0011304): Increased thumb width without increased dorso-ventral dimension. Evidence: TAS. Frequency: Very frequent (HP:0040281). (ORPHA:353277)
- Neurodevelopmental delay (HP:0012758): Neurodevelopmental delay (NDD) refers to delays in the maturation of the brain and central nervous system; infants and young children with NDD may experience delays in the development of one or more skills including gross motor abilities, fine-motor coordination, language abilities and ability to solve increasingly complex problems. Evidence: TAS. Frequency: Very frequent (HP:0040281). (ORPHA:353277)
- Cryptorchidism (HP:0000028): Testis in inguinal canal. That is, absence of one or both testes from the scrotum owing to failure of the testis or testes to descend through the inguinal canal to the scrotum. Evidence: TAS. Frequency: Frequent (HP:0040282). (ORPHA:353277)
- Abnormality of the kidney (HP:0000077): An abnormality of the kidney. Evidence: TAS. Frequency: Frequent (HP:0040282). (ORPHA:353277)
- Abnormality of the genitourinary system (HP:0000119): The presence of any abnormality of the genitourinary system. Evidence: TAS. Frequency: Frequent (HP:0040282). (ORPHA:353277)
- Narrow palate (HP:0000189): Width of the palate more than 2 SD below the mean (objective) or apparently decreased palatal width (subjective). Evidence: TAS. Frequency: Frequent (HP:0040282). (ORPHA:353277)
- Convex nasal ridge (HP:0000444): Nasal ridge curving anteriorly to an imaginary line that connects the nasal root and tip. The nose appears often also prominent, and the columella low. Evidence: TAS. Frequency: Frequent (HP:0040282). (ORPHA:353277)
- Abnormality of the eye (HP:0000478): Any abnormality of the eye, including location, spacing, and intraocular abnormalities. Evidence: TAS. Frequency: Frequent (HP:0040282). (ORPHA:353277)
- Ptosis (HP:0000508): The upper eyelid margin is positioned 3 mm or more lower than usual and covers the superior portion of the iris (objective); or, the upper lid margin obscures at least part of the pupil (subjective). Evidence: TAS. Frequency: Frequent (HP:0040282). (ORPHA:353277)
- Atypical behavior (HP:0000708): Atypical behavior is an abnormality in a person's actions that can be controlled or modulated by the will of the individual. While abnormal behaviors can be difficult to control, they are distinct from other abnormal actions that cannot be affected by the individual's will. Evidence: TAS. Frequency: Frequent (HP:0040282). (ORPHA:353277)
- Emotional lability (HP:0000712): Unstable emotional experiences and frequent mood changes; emotions that are easily aroused, intense, and/or disproportionate to events and circumstances. Evidence: TAS. Frequency: Frequent (HP:0040282). (ORPHA:353277)
- Compulsive behaviors (HP:0000722): Behavior that consists of repetitive acts, characterized by the feeling that one "has to" perform them, while being aware that these acts are not in line with one's overall goal. Evidence: TAS. Frequency: Frequent (HP:0040282). (ORPHA:353277)
- Motor stereotypy (HP:0000733): Use of the same abnormal action in response to certain triggers or at random. They may be used as a way to regulate one's internal state but must otherwise have no apparent functional purpose. Evidence: TAS. Frequency: Frequent (HP:0040282). (ORPHA:353277)
- Agoraphobia (HP:0000756): A type of anxiety disorder characterized by the avoidance of public places, especially where crowds gather. Evidence: TAS. Frequency: Frequent (HP:0040282). (ORPHA:353277)
- Failure to thrive (HP:0001508): Failure to thrive (FTT) refers to a child whose physical growth is substantially below the norm. Evidence: TAS. Frequency: Frequent (HP:0040282). (ORPHA:353277)
- Obesity (HP:0001513): Accumulation of substantial excess body fat. Evidence: TAS. Frequency: Frequent (HP:0040282). (ORPHA:353277)
- Abnormal heart morphology (HP:0001627): Any structural anomaly of the heart. Evidence: TAS. Frequency: Frequent (HP:0040282). (ORPHA:353277)
- Constipation (HP:0002019): Infrequent or difficult evacuation of feces. Evidence: TAS. Frequency: Frequent (HP:0040282). (ORPHA:353277)
- Recurrent respiratory infections (HP:0002205): An increased susceptibility to respiratory infections as manifested by a history of recurrent respiratory infections. Evidence: TAS. Frequency: Frequent (HP:0040282). (ORPHA:353277)
- Obstructive sleep apnea (HP:0002870): Obstructive Sleep Apnea is a condition characterized by the obstruction of the airway and pauses in breathing during sleep, which occur multiple times throughout the night. It is related to the relaxation of muscle tone that typically happens during sleep, leading to a partial collapse of the soft tissues in the airway and causing airflow obstruction. Evidence: TAS. Frequency: Frequent (HP:0040282). (ORPHA:353277)
- Short stature (HP:0004322): A height below that which is expected according to age and gender norms. Although there is no universally accepted definition of short stature, many refer to "short stature" as height more than 2 standard deviations below the mean for age and gender (or below the 3rd percentile for age and gender dependent norms). Evidence: TAS. Frequency: Frequent (HP:0040282). (ORPHA:353277)
- Social and occupational deterioration (HP:0007086). Evidence: TAS. Frequency: Frequent (HP:0040282). (ORPHA:353277)
- Laryngeal cartilage malformation (HP:0008752): A malformation of the laryngeal cartilage. Evidence: TAS. Frequency: Frequent (HP:0040282). (ORPHA:353277)
- Feeding difficulties in infancy (HP:0008872): Impaired feeding performance of an infant as manifested by difficulties such as weak and ineffective sucking, brief bursts of sucking, and falling asleep during sucking. There may be difficulties with chewing or maintaining attention. Evidence: TAS. Frequency: Frequent (HP:0040282). (ORPHA:353277)
- Low hanging columella (HP:0009765): Columella extending inferior to the level of the nasal base, when viewed from the side. Evidence: TAS. Frequency: Frequent (HP:0040282). (ORPHA:353277)
- Abnormal proximal phalanx morphology of the hand (HP:0009834). Evidence: TAS. Frequency: Frequent (HP:0040282). (ORPHA:353277)
- Broad distal phalanx of finger (HP:0009836): Abnormally wide (broad) distal phalanx of finger. Evidence: TAS. Frequency: Frequent (HP:0040282). (ORPHA:353277)
- Talon cusp (HP:0011087): Talon cusp is an accessory cusp located near the cingulum (the portion of the lingual or palatal aspect of the tooth that forms a convex protuberance at the cervical third of the anatomic crown). Evidence: TAS. Frequency: Frequent (HP:0040282). (ORPHA:353277)
- Reduced social responsiveness (HP:0012760): A reduced ability to participate in the back-and-forth flow of social interaction appropriate to culture and developmental level, which is normally characterized by an influence of the behavior of one person on the behavior of another person. This results in difficulty interacting with others through emotional, physical, or verbal communication. Evidence: TAS. Frequency: Frequent (HP:0040282). (ORPHA:353277)
- Panic attack (HP:0025269): A sudden episode of intense fear in a situation where there is no danger or apparent cause. Evidence: TAS. Frequency: Frequent (HP:0040282). (ORPHA:353277)
- Abnormal cardiovascular system morphology (HP:0030680): Any structural anomaly of the heart and blood vessels. Evidence: TAS. Frequency: Frequent (HP:0040282). (ORPHA:353277)
- Impulsivity (HP:0100710): Acting on the spur of the moment or on a momentary basis without consideration of outcomes; having difficulty establishing or following plans; experiencing a sense of urgency and engaging in behavior that is uninhibited, cannot be inhibited, and is uncontrolled. The possibility of repression is inconceivable. Evidence: TAS. Frequency: Frequent (HP:0040282). (ORPHA:353277)
- Abnormal fear-induced behavior (HP:0100852): An abnormal fear-induced behavior includes observable actions. This behavior is characterized by abnormal responses to fear or abnormal fear levels. Examples of such behavior include avoiding fear-inducing situations. Evidence: TAS. Frequency: Frequent (HP:0040282). (ORPHA:353277)
- Brain imaging abnormality (HP:0410263): An anomaly of metabolism or structure of the brain identified by imaging. Evidence: TAS. Frequency: Frequent (HP:0040282). (ORPHA:353277)
- Recurrent urinary tract infections (HP:0000010): Repeated infections of the urinary tract. Evidence: TAS. Frequency: Occasional (HP:0040283). (ORPHA:353277)
- Hydrocele testis (HP:0000034): Accumulation of clear fluid in the between the layers of membrane (tunica vaginalis) surrounding the testis. Evidence: TAS. Frequency: Occasional (HP:0040283). (ORPHA:353277)
- Hypospadias (HP:0000047): Abnormal position of urethral meatus on the ventral penile shaft (underside) characterized by displacement of the urethral meatus from the tip of the glans penis to the ventral surface of the penis, scrotum, or perineum. Evidence: TAS. Frequency: Occasional (HP:0040283). (ORPHA:353277)
- Vesicoureteral reflux (HP:0000076): Abnormal (retrograde) movement of urine from the bladder into ureters or kidneys related to inadequacy of the valvular mechanism at the ureterovesicular junction or other causes. Evidence: TAS. Frequency: Occasional (HP:0040283). (ORPHA:353277)
- Abnormality of the urinary system (HP:0000079): An abnormality of the urinary system. Evidence: TAS. Frequency: Occasional (HP:0040283). (ORPHA:353277)
- Hydronephrosis (HP:0000126): Severe distention of the kidney with dilation of the renal pelvis and calices. Evidence: TAS. Frequency: Occasional (HP:0040283). (ORPHA:353277)
- Otitis media (HP:0000388): Inflammation or infection of the middle ear. Evidence: TAS. Frequency: Occasional (HP:0040283). (ORPHA:353277)
- Conductive hearing impairment (HP:0000405): An abnormality of vibrational conductance of sound to the inner ear leading to impairment of sensory perception of sound. Evidence: TAS. Frequency: Occasional (HP:0040283). (ORPHA:353277)
- Strabismus (HP:0000486): A misalignment of the eyes so that the visual axes deviate from bifoveal fixation. The classification of strabismus may be based on a number of features including the relative position of the eyes, whether the deviation is latent or manifest, intermittent or constant, concomitant or otherwise and according to the age of onset and the relevance of any associated refractive error. Evidence: TAS. Frequency: Occasional (HP:0040283). (ORPHA:353277)
- Glaucoma (HP:0000501): Glaucoma refers loss of retinal ganglion cells in a characteristic pattern of optic neuropathy usually associated with increased intraocular pressure. Evidence: TAS. Frequency: Occasional (HP:0040283). (ORPHA:353277)
- Hypermetropia (HP:0000540): An abnormality of refraction characterized by the ability to see objects in the distance clearly, while objects nearby appear blurry. Evidence: TAS. Frequency: Occasional (HP:0040283). (ORPHA:353277)
- Corneal scarring (HP:0000559). Evidence: TAS. Frequency: Occasional (HP:0040283). (ORPHA:353277)
- Nasolacrimal duct obstruction (HP:0000579): Blockage of the lacrimal duct. Evidence: TAS. Frequency: Occasional (HP:0040283). (ORPHA:353277)
- Nystagmus (HP:0000639): Rhythmic, involuntary oscillations of one or both eyes related to abnormality in fixation, conjugate gaze, or vestibular mechanisms. Evidence: TAS. Frequency: Occasional (HP:0040283). (ORPHA:353277)
- Hypodontia (HP:0000668): The absence of five or less teeth from the normal series by a failure to develop. Evidence: TAS. Frequency: Occasional (HP:0040283). (ORPHA:353277)
- Carious teeth (HP:0000670): Caries is a multifactorial bacterial infection affecting the structure of the tooth. This term has been used to describe the presence of more than expected dental caries. Evidence: TAS. Frequency: Occasional (HP:0040283). (ORPHA:353277)
- Dental crowding (HP:0000678): Changes in alignment of teeth in the dental arch. Evidence: TAS. Frequency: Occasional (HP:0040283). (ORPHA:353277)
- Dental malocclusion (HP:0000689): Dental malocclusion refers to an abnormality of the occlusion, or alignment, of the teeth and the way the upper and lower teeth fit together, resulting in overcrowding of teeth or in abnormal bite patterns. Evidence: TAS. Frequency: Occasional (HP:0040283). (ORPHA:353277)
- Aggressive behavior (HP:0000718): Behavior or an act aimed at harming a person, animal, or physical property (e.g., acts of physical violence; shouting, swearing, and using harsh language; slashing someone's tires). Evidence: TAS. Frequency: Occasional (HP:0040283). (ORPHA:353277)
- Hyperactivity (HP:0000752): Hyperactivity is a condition characterized by constant and unusually high levels of activity, even in situations where it is deemed inappropriate. Evidence: TAS. Frequency: Occasional (HP:0040283). (ORPHA:353277)
- Kidney stone (HP:0000787): Kidney stones (calculi) are mineral concretions in the renal calyces and pelvis that are found free or attached to the renal papillae. Evidence: TAS. Frequency: Occasional (HP:0040283). (ORPHA:353277)
- Abnormal posterior cranial fossa morphology (HP:0000932): An abnormality of the fossa cranii posterior (the posterior fossa), which is made up primarily of the occipital bone and which surrounds to the foramen magnum. Evidence: TAS. Frequency: Occasional (HP:0040283). (ORPHA:353277)
- Trichiasis (HP:0001128): Inversion and rubbing of the eyelashes against the globe of the eye. Evidence: TAS. Frequency: Occasional (HP:0040283). (ORPHA:353277)
- Syndactyly (HP:0001159): Webbing or fusion of the fingers or toes, involving soft parts only or including bone structure. Bony fusions are referred to as "bony" syndactyly if the fusion occurs in a radio-ulnar axis. Fusions of bones of the fingers or toes in a proximo-distal axis are referred to as "symphalangism". Evidence: TAS. Frequency: Occasional (HP:0040283). (ORPHA:353277)
- Adducted thumb (HP:0001181): In the resting position, the tip of the thumb is on, or near, the palm, close to the base of the fourth or fifth finger. Evidence: TAS. Frequency: Occasional (HP:0040283). (ORPHA:353277)
- Hypotonia (HP:0001252): Hypotonia is an abnormally low muscle tone (the amount of tension or resistance to movement in a muscle). Even when relaxed, muscles have a continuous and passive partial contraction which provides some resistance to passive stretching. Hypotonia thus manifests as diminished resistance to passive stretching. Hypotonia is not the same as muscle weakness, although the two conditions can co-exist. Evidence: TAS. Frequency: Occasional (HP:0040283). (ORPHA:353277)
- Abnormal corpus callosum morphology (HP:0001273): Abnormality of the corpus callosum. Evidence: TAS. Frequency: Occasional (HP:0040283). (ORPHA:353277)
- Absent speech (HP:0001344): Complete lack of development of speech and language abilities. Evidence: TAS. Frequency: Occasional (HP:0040283). (ORPHA:353277)
- Joint hypermobility (HP:0001382): The capability that a joint (or a group of joints) has to move, passively and/or actively, beyond normal limits along physiological axes. Evidence: TAS. Frequency: Occasional (HP:0040283). (ORPHA:353277)
- Hip dysplasia (HP:0001385): The presence of developmental dysplasia of the hip. Evidence: TAS. Frequency: Occasional (HP:0040283). (ORPHA:353277)
- Intrauterine growth retardation (HP:0001511): An abnormal restriction of fetal growth with fetal weight below the tenth percentile for gestational age. Evidence: TAS. Frequency: Occasional (HP:0040283). (ORPHA:353277)
- Polyhydramnios (HP:0001561): The presence of excess amniotic fluid in the uterus during pregnancy. Evidence: TAS. Frequency: Occasional (HP:0040283). (ORPHA:353277)
- Ventricular septal defect (HP:0001629): A hole between the two bottom chambers (ventricles) of the heart. The defect is centered around the most superior aspect of the ventricular septum. Evidence: TAS. Frequency: Occasional (HP:0040283). (ORPHA:353277)
- Atrial septal defect (HP:0001631): Atrial septal defect (ASD) is a congenital abnormality of the interatrial septum that enables blood flow between the left and right atria via the interatrial septum. Evidence: TAS. Frequency: Occasional (HP:0040283). (ORPHA:353277)
- Patent ductus arteriosus (HP:0001643): In utero, the ductus arteriosus (DA) serves to divert ventricular output away from the lungs and toward the placenta by connecting the main pulmonary artery to the descending aorta. A patent ductus arteriosus (PDA) in the first 3 days of life is a physiologic shunt in healthy term and preterm newborn infants, and normally is substantially closed within about 24 hours after bith and completely closed after about three weeks. Failure of physiologcal closure is referred to a persistent or patent ductus arteriosus (PDA). Depending on the degree of left-to-right shunting, PDA can have clinical consequences. Evidence: TAS. Frequency: Occasional (HP:0040283). (ORPHA:353277)
- Patent foramen ovale (HP:0001655): Failure of the foramen ovale to seal postnatally, leaving a potential conduit between the left and right cardiac atria. Evidence: TAS. Frequency: Occasional (HP:0040283). (ORPHA:353277)
- Gastroesophageal reflux (HP:0002020): A condition in which the stomach contents leak backwards from the stomach into the esophagus through the lower esophageal sphincter. Evidence: TAS. Frequency: Occasional (HP:0040283). (ORPHA:353277)
- Pneumonia (HP:0002090): Inflammation of any part of the lung parenchyma. Evidence: TAS. Frequency: Occasional (HP:0040283). (ORPHA:353277)
- Chiari malformation (HP:0002308): Chiari malformation consists of a downward displacement of the cerebellar tonsils and the medulla through the foramen magnum, sometimes causing hydrocephalus as a result of obstruction of CSF outflow. Evidence: TAS. Frequency: Occasional (HP:0040283). (ORPHA:353277)
- Aspiration (HP:0002835): Inspiration of a foreign object into the airway. Evidence: TAS. Frequency: Occasional (HP:0040283). (ORPHA:353277)
- Meningioma (HP:0002858): The presence of a meningioma, i.e., a benign tumor originating from the dura mater or arachnoid mater. Evidence: TAS. Frequency: Occasional (HP:0040283). (ORPHA:353277)
- Patellar dislocation (HP:0002999): The kneecap normally is located within the groove termed trochlea on the distal femur and can slide up and down in it. Patellar dislocation occurs if the patella fully dislocates out of the groove. Evidence: TAS. Frequency: Occasional (HP:0040283). (ORPHA:353277)
- Abnormality of the cervical spine (HP:0003319): Any abnormality of the cervical vertebral column. Evidence: TAS. Frequency: Occasional (HP:0040283). (ORPHA:353277)
- Avascular necrosis of the capital femoral epiphysis (HP:0005743): Avascular necrosis of the proximal epiphysis of the femur occurring in growing children and caused by an interruption of the blood supply to the head of the femur close to the hip joint. The necrosis is characteristically associated with flattening of the femoral head, for which reason the term coxa plana has been used to refer to this feature in the medical literature. Evidence: TAS. Frequency: Occasional (HP:0040283). (ORPHA:353277)
- Chiari type I malformation (HP:0007099): Arnold-Chiari type I malformation refers to a relatively mild degree of herniation of the posteroinferior region of the cerebellum (the cerebellar tonsils) into the cervical canal with little or no displacement of the fourth ventricle. It is characterized by one or both pointed (not rounded) cerebellar tonsils that project 5 mm below the foramen magnum, measured by a line drawn from the basion to the opisthion (McRae Line). Evidence: TAS. Frequency: Occasional (HP:0040283). (ORPHA:353277)
- Deviation of the hallux (HP:0010051): Displacement of the big toe from its normal position. Evidence: TAS. Frequency: Occasional (HP:0040283). (ORPHA:353277)
- Polydactyly (HP:0010442): A congenital anomaly characterized by the presence of supernumerary fingers or toes. Evidence: TAS. Frequency: Occasional (HP:0040283). (ORPHA:353277)
- Abnormal curvature of the vertebral column (HP:0010674): The presence of an abnormal curvature of the vertebral column. Evidence: TAS. Frequency: Occasional (HP:0040283). (ORPHA:353277)
- Supernumerary tooth (HP:0011069): The presence of one or more teeth additional to the normal number. Evidence: TAS. Frequency: Occasional (HP:0040283). (ORPHA:353277)
- Nasogastric tube feeding in infancy (HP:0011470): Feeding problem necessitating nasogastric tube feeding. Evidence: TAS. Frequency: Occasional (HP:0040283). (ORPHA:353277)
- Delayed myelination (HP:0012448): Delayed myelination. Evidence: TAS. Frequency: Occasional (HP:0040283). (ORPHA:353277)
- Abnormal lateral ventricle morphology (HP:0030047): A morphological anomaly of the lateral ventricle. Evidence: TAS. Frequency: Occasional (HP:0040283). (ORPHA:353277)
- Abnormal subclavian artery morphology (HP:0031251): Any anomaly of a subclavian artery. Evidence: TAS. Frequency: Occasional (HP:0040283). (ORPHA:353277)
- Cardiac conduction abnormality (HP:0031546): Any anomaly of the progression of electrical impulses through the heart. Evidence: TAS. Frequency: Occasional (HP:0040283). (ORPHA:353277)
- Self-injurious behavior (HP:0100716): Self-aggression. Evidence: TAS. Frequency: Occasional (HP:0040283). (ORPHA:353277)
- Sensorineural hearing impairment (HP:0000407): A type of hearing impairment in one or both ears related to an abnormal functionality of the cochlear nerve. Evidence: TAS. Frequency: Very rare (HP:0040284). (ORPHA:353277)
- Cataract (HP:0000518): A cataract is an opacity or clouding that develops in the crystalline lens of the eye or in its capsule. Evidence: TAS. Frequency: Very rare (HP:0040284). (ORPHA:353277)
- Coloboma (HP:0000589): A developmental defect characterized by a cleft of some portion of the eye or ocular adnexa. Evidence: TAS. Frequency: Very rare (HP:0040284). (ORPHA:353277)
- Natal tooth (HP:0000695): A tooth present at birth or erupting within the first month of life. Evidence: TAS. Frequency: Very rare (HP:0040284). (ORPHA:353277)
- Seizure (HP:0001250): A seizure is an intermittent abnormality of nervous system physiology characterized by a transient occurrence of signs and/or symptoms due to abnormal excessive or synchronous neuronal activity in the brain. Evidence: TAS. Frequency: Very rare (HP:0040284). (ORPHA:353277)
- Pulmonic stenosis (HP:0001642): A narrowing of the right ventricular outflow tract that can occur at the pulmonary valve (valvular stenosis), below the pulmonary valve (infundibular stenosis), or above the pulmonary valve (supravalvar stenosis). Evidence: TAS. Frequency: Very rare (HP:0040284). (ORPHA:353277)
- Bicuspid aortic valve (HP:0001647): The presence of an aortic valve with two instead of the normal three cusps (flaps). Bicuspid aortic valvue is a malformation of a commissure (small space between the attachment of each cusp to the aortic wall) and the adjacent parts of the two corresponding cusps forming a raphe (the fused area of the two underdeveloped cusps turning into a malformed commissure between both cusps; the raphe is a fibrous ridge that extends from the commissure to the free edge of the two underdeveloped, conjoint cusps). Evidence: TAS. Frequency: Very rare (HP:0040284). (ORPHA:353277)
- Aortic valve stenosis (HP:0001650): The presence of a stenosis (narrowing) of the aortic valve. Evidence: TAS. Frequency: Very rare (HP:0040284). (ORPHA:353277)
- Coarctation of aorta (HP:0001680): Coarctation of the aorta is a narrowing or constriction of a segment of the aorta. Evidence: TAS. Frequency: Very rare (HP:0040284). (ORPHA:353277)
- Asthma (HP:0002099): Asthma is characterized by increased responsiveness of the tracheobronchial tree to multiple stimuli, leading to narrowing of the air passages with resultant dyspnea, cough, and wheezing. Evidence: TAS. Frequency: Very rare (HP:0040284). (ORPHA:353277)
- Cervical cord compression (HP:0002341): Compression of the spinal cord in the cervical region, generally manifested by paresthesias and numbness, weakness, difficulty walking, abnormalities of coordination, and neck pain or stiffness. Evidence: TAS. Frequency: Very rare (HP:0040284). (ORPHA:353277)
- EEG abnormality (HP:0002353): Abnormality observed by electroencephalogram (EEG), which is used to record of the brain's spontaneous electrical activity from multiple electrodes placed on the scalp. Evidence: TAS. Frequency: Very rare (HP:0040284). (ORPHA:353277)
- Intestinal malrotation (HP:0002566): An abnormality of the intestinal rotation and fixation that normally occurs during the development of the gut. This can lead to volvulus, or twisting of the intestine that causes obstruction and necrosis. Evidence: TAS. Frequency: Very rare (HP:0040284). (ORPHA:353277)
- Syringomyelia (HP:0003396): Dilated, glial-lined cavity in spinal cord. This cavity does not communicate with the central canal, and usually is between the dorsal columns unilaterally or bilaterally along the side of the cord. Evidence: TAS. Frequency: Very rare (HP:0040284). (ORPHA:353277)
- Humoral immunodeficiency (HP:0005363): A general term referring to a defect in immunity resulting from impaired antibody production. Evidence: TAS. Frequency: Very rare (HP:0040284). (ORPHA:353277)
- Cellular immunodeficiency (HP:0005374): An immunodeficiency characterized by defective cell-mediated immunity or humoral immunity. Evidence: TAS. Frequency: Very rare (HP:0040284). (ORPHA:353277)
- Keloids (HP:0010562). Evidence: TAS. Frequency: Very rare (HP:0040284). (ORPHA:353277)
- Vascular ring (HP:0010775): A developmental defect of the aortic arch system in which the trachea and esophagus are completely encircled by connected segments of the aortic arch and its branches. This occurs if the normal process of regression and persistence of the bilateral embryonic aortic arches fails. Evidence: TAS. Frequency: Very rare (HP:0040284). (ORPHA:353277)
- Pilomatrixoma (HP:0030434): Pilomatricoma is an asymptomatic slowly growing benign cutaneous tumor, differentiating towards the hair matrix of the hair follicle. It is covered by normal or hyperemic skin, and usually varies in size from 0.5 to 3 cm. Evidence: TAS. Frequency: Very rare (HP:0040284). (ORPHA:353277)
These phenotypes are associated with the disease Rubinstein-Taybi syndrome due to CREBBP mutations (ORPHA:353277).